Phenotypes associated with the disease Intellectual disability syndrome due to a DYRK1A point mutation (ORPHA:464311):
- Microcephaly (HP:0000252): Head circumference below 2 standard deviations below the mean for age and gender. Evidence: TAS. Frequency: Very frequent (HP:0040281). (ORPHA:464311)
- Atypical behavior (HP:0000708): Atypical behavior is an abnormality in a person's actions that can be controlled or modulated by the will of the individual. While abnormal behaviors can be difficult to control, they are distinct from other abnormal actions that cannot be affected by the individual's will. Evidence: TAS. Frequency: Very frequent (HP:0040281). (ORPHA:464311)
- Delayed speech and language development (HP:0000750): A degree of language development that is significantly below the norm for a child of a specified age. Evidence: TAS. Frequency: Very frequent (HP:0040281). (ORPHA:464311)
- Intellectual disability (HP:0001249): The term intellectual disability or intellectual developmental disorder is used to describe significantly sub-average intellectual and adaptive functioning based on clinical assessment and as measured by individually administered, appropriately normed, standardized and validated tests of intellectual functioning and adaptive behavior, with onset during the developmental period from infancy through adolescence. Evidence: TAS. Frequency: Very frequent (HP:0040281). (ORPHA:464311)
- Global developmental delay (HP:0001263): A delay in the achievement of motor or mental milestones in the domains of development of a child, including motor skills, speech and language, cognitive skills, and social and emotional skills. This term should only be used to describe children younger than five years of age. Evidence: TAS. Frequency: Very frequent (HP:0040281). (ORPHA:464311)
- Abnormal facial shape (HP:0001999): An abnormal morphology (form) of the face or its components. Evidence: TAS. Frequency: Very frequent (HP:0040281). (ORPHA:464311)
- Feeding difficulties (HP:0011968): Impaired ability to eat related to problems gathering food and getting ready to suck, chew, or swallow it. Evidence: TAS. Frequency: Very frequent (HP:0040281). (ORPHA:464311)
- Abnormality of vision (HP:0000504): Abnormality of eyesight (visual perception). Evidence: TAS. Frequency: Frequent (HP:0040282). (ORPHA:464311)
- Autistic behavior (HP:0000729): Persistent deficits in social interaction and communication and interaction as well as a markedly restricted repertoire of activity and interest as well as repetitive patterns of behavior. Evidence: TAS. Frequency: Frequent (HP:0040282). (ORPHA:464311)
- Motor stereotypy (HP:0000733): Use of the same abnormal action in response to certain triggers or at random. They may be used as a way to regulate one's internal state but must otherwise have no apparent functional purpose. Evidence: TAS. Frequency: Frequent (HP:0040282). (ORPHA:464311)
- Anxiety (HP:0000739): Intense feelings of nervousness, tension, or panic often arise in response to interpersonal stresses. There is worry about the negative effects of past unpleasant experiences and future negative possibilities. Individuals may feel fearful, apprehensive, or threatened by uncertainty, and they may also have fears of falling apart or losing control. Evidence: TAS. Frequency: Frequent (HP:0040282). (ORPHA:464311)
- Seizure (HP:0001250): A seizure is an intermittent abnormality of nervous system physiology characterized by a transient occurrence of signs and/or symptoms due to abnormal excessive or synchronous neuronal activity in the brain. Evidence: TAS. Frequency: Frequent (HP:0040282). (ORPHA:464311)
- Motor delay (HP:0001270): A type of Developmental delay characterized by a delay in acquiring motor skills. Evidence: TAS. Frequency: Frequent (HP:0040282). (ORPHA:464311)
- Gait disturbance (HP:0001288): The term gait disturbance can refer to any disruption of the ability to walk. Evidence: TAS. Frequency: Frequent (HP:0040282). (ORPHA:464311)
- Absent speech (HP:0001344): Complete lack of development of speech and language abilities. Evidence: TAS. Frequency: Frequent (HP:0040282). (ORPHA:464311)
- Failure to thrive (HP:0001508): Failure to thrive (FTT) refers to a child whose physical growth is substantially below the norm. Evidence: TAS. Frequency: Frequent (HP:0040282). (ORPHA:464311)
- Intrauterine growth retardation (HP:0001511): An abnormal restriction of fetal growth with fetal weight below the tenth percentile for gestational age. Evidence: TAS. Frequency: Frequent (HP:0040282). (ORPHA:464311)
- Small for gestational age (HP:0001518): Smaller than normal size according to sex and gestational age related norms, defined as a weight below the 10th percentile for the gestational age. Evidence: TAS. Frequency: Frequent (HP:0040282). (ORPHA:464311)
- Ventriculomegaly (HP:0002119): An increase in size of the ventricular system of the brain. Evidence: TAS. Frequency: Frequent (HP:0040282). (ORPHA:464311)
- Cerebral cortical atrophy (HP:0002120): Atrophy of the cortex of the cerebrum. Evidence: TAS. Frequency: Frequent (HP:0040282). (ORPHA:464311)
- Birth length less than 3rd percentile (HP:0003561). Evidence: TAS. Frequency: Frequent (HP:0040282). (ORPHA:464311)
- Abnormal axial skeleton morphology (HP:0009121): An abnormality of the axial skeleton, which comprises the skull, the vertebral column, the ribs and the sternum. Evidence: TAS. Frequency: Frequent (HP:0040282). (ORPHA:464311)
- Brain imaging abnormality (HP:0410263): An anomaly of metabolism or structure of the brain identified by imaging. Evidence: TAS. Frequency: Frequent (HP:0040282). (ORPHA:464311)
- Narrow forehead (HP:0000341): Width of the forehead or distance between the frontotemporales is more than two standard deviations below the mean (objective); or apparently narrow intertemporal region (subjective). Evidence: TAS. Frequency: Occasional (HP:0040283). (ORPHA:464311)
- Protruding ear (HP:0000411): Angle formed by the plane of the ear and the mastoid bone greater than the 97th centile for age (objective); or, outer edge of the helix more than 2 cm from the mastoid at the point of maximum distance (objective). Evidence: TAS. Frequency: Occasional (HP:0040283). (ORPHA:464311)
- Prominent nasal bridge (HP:0000426): Anterior positioning of the nasal root in comparison to the usual positioning for age. Evidence: TAS. Frequency: Occasional (HP:0040283). (ORPHA:464311)
- Astigmatism (HP:0000483): A type of refraction error associated with abnormal curvatures on the anterior and/or posterior surface of the cornea. Evidence: TAS. Frequency: Occasional (HP:0040283). (ORPHA:464311)
- Strabismus (HP:0000486): A misalignment of the eyes so that the visual axes deviate from bifoveal fixation. The classification of strabismus may be based on a number of features including the relative position of the eyes, whether the deviation is latent or manifest, intermittent or constant, concomitant or otherwise and according to the age of onset and the relevance of any associated refractive error. Evidence: TAS. Frequency: Occasional (HP:0040283). (ORPHA:464311)
- Deeply set eye (HP:0000490): An eye that is more deeply recessed into the plane of the face than is typical. Evidence: TAS. Frequency: Occasional (HP:0040283). (ORPHA:464311)
- Hypermetropia (HP:0000540): An abnormality of refraction characterized by the ability to see objects in the distance clearly, while objects nearby appear blurry. Evidence: TAS. Frequency: Occasional (HP:0040283). (ORPHA:464311)
- Optic disc pallor (HP:0000543): A pale yellow discoloration of the optic disc (the area of the optic nerve head in the retina). The optic disc normally has a pinkish hue with a central yellowish depression. Evidence: TAS. Frequency: Occasional (HP:0040283). (ORPHA:464311)
- Myopia (HP:0000545): An abnormality of refraction characterized by the ability to see objects nearby clearly, while objects in the distance appear blurry. Evidence: TAS. Frequency: Occasional (HP:0040283). (ORPHA:464311)
- Exotropia (HP:0000577): A form of strabismus with one or both eyes deviated outward. Evidence: TAS. Frequency: Occasional (HP:0040283). (ORPHA:464311)
- Amblyopia (HP:0000646): Reduced visual acuity that is uncorrectable by lenses in the absence of detectable anatomic defects in the eye or visual pathways. Evidence: TAS. Frequency: Occasional (HP:0040283). (ORPHA:464311)
- Pectus excavatum (HP:0000767): A defect of the chest wall characterized by a depression of the sternum, giving the chest ("pectus") a caved-in ("excavatum") appearance. Evidence: TAS. Frequency: Occasional (HP:0040283). (ORPHA:464311)
- Tapered finger (HP:0001182): The gradual reduction in girth of the finger from proximal to distal. Evidence: TAS. Frequency: Occasional (HP:0040283). (ORPHA:464311)
- Short foot (HP:0001773): A measured foot length that is more than 2 SD below the mean for a newborn of 27 - 41 weeks gestation, or foot that is less than the 3rd centile for individuals from birth to 16 years of age (objective). Alternatively, a foot that appears disproportionately short (subjective). Evidence: TAS. Frequency: Occasional (HP:0040283). (ORPHA:464311)
- Short toe (HP:0001831): A toe that appears disproportionately short compared to the foot. Evidence: TAS. Frequency: Occasional (HP:0040283). (ORPHA:464311)
- Vomiting (HP:0002013): Forceful ejection of the contents of the stomach through the mouth by means of a series of involuntary spasmic contractions. Evidence: TAS. Frequency: Occasional (HP:0040283). (ORPHA:464311)
- Gastroesophageal reflux (HP:0002020): A condition in which the stomach contents leak backwards from the stomach into the esophagus through the lower esophageal sphincter. Evidence: TAS. Frequency: Occasional (HP:0040283). (ORPHA:464311)
- Hypoplasia of the corpus callosum (HP:0002079): Underdevelopment of the corpus callosum. Evidence: TAS. Frequency: Occasional (HP:0040283). (ORPHA:464311)
- Abnormal brainstem morphology (HP:0002363): An anomaly of the brainstem. Evidence: TAS. Frequency: Occasional (HP:0040283). (ORPHA:464311)
- Scoliosis (HP:0002650): The presence of an abnormal lateral curvature of the spine. Evidence: TAS. Frequency: Occasional (HP:0040283). (ORPHA:464311)
- Recurrent infections (HP:0002719): Increased susceptibility to infections as manifested by repeated bouts of infection. Evidence: TAS. Frequency: Occasional (HP:0040283). (ORPHA:464311)
- Kyphosis (HP:0002808): Exaggerated anterior convexity of the thoracic vertebral column. Evidence: TAS. Frequency: Occasional (HP:0040283). (ORPHA:464311)
- Abnormality of the cervical spine (HP:0003319): Any abnormality of the cervical vertebral column. Evidence: TAS. Frequency: Occasional (HP:0040283). (ORPHA:464311)
- Ankle flexion contracture (HP:0006466). Evidence: TAS. Frequency: Occasional (HP:0040283). (ORPHA:464311)
- Attention deficit hyperactivity disorder (HP:0007018): Attention deficit hyperactivity disorder (ADHD) manifests at age 2-3 years or by first grade at the latest. The main symptoms are distractibility, impulsivity, hyperactivity, and often trouble organizing tasks and projects, difficulty going to sleep, and social problems from being aggressive, loud, or impatient. Evidence: TAS. Frequency: Occasional (HP:0040283). (ORPHA:464311)
- Corneal opacity (HP:0007957): A reduction of corneal clarity. Evidence: TAS. Frequency: Occasional (HP:0040283). (ORPHA:464311)
- Simple febrile seizure (HP:0011171): A short generalized seizure, of a duration of <15 min, not recurring within 24 h, occurring during a febrile episode not caused by an acute disease of the nervous system intracranial infection or severe metabolic disturbance. Evidence: TAS. Frequency: Occasional (HP:0040283). (ORPHA:464311)
- Posterior pituitary hypoplasia (HP:0011757): Underdevelopment of the neurohypophysis. Evidence: TAS. Frequency: Occasional (HP:0040283). (ORPHA:464311)
- Flexion contracture of finger (HP:0012785): Chronic loss of joint motion in a finger due to structural changes in non-bony tissue. Evidence: TAS. Frequency: Occasional (HP:0040283). (ORPHA:464311)
- Cryptorchidism (HP:0000028): Testis in inguinal canal. That is, absence of one or both testes from the scrotum owing to failure of the testis or testes to descend through the inguinal canal to the scrotum. Evidence: TAS. Frequency: Very rare (HP:0040284). (ORPHA:464311)
- Hypospadias (HP:0000047): Abnormal position of urethral meatus on the ventral penile shaft (underside) characterized by displacement of the urethral meatus from the tip of the glans penis to the ventral surface of the penis, scrotum, or perineum. Evidence: TAS. Frequency: Very rare (HP:0040284). (ORPHA:464311)
- Micropenis (HP:0000054): Abnormally small penis. At birth, the normal penis is about 3 cm (stretched length from pubic tubercle to tip of penis) with micropenis less than 2.0-2.5 cm. Evidence: TAS. Frequency: Very rare (HP:0040284). (ORPHA:464311)
- Renal cyst (HP:0000107): A fluid filled sac in the kidney. Evidence: TAS. Frequency: Very rare (HP:0040284). (ORPHA:464311)
- Unilateral renal agenesis (HP:0000122): A unilateral form of agenesis of the kidney. Evidence: TAS. Frequency: Very rare (HP:0040284). (ORPHA:464311)
- Pelvic kidney (HP:0000125): A developmental defect in which a kidney is located in an abnormal anatomic position within the pelvis. Evidence: TAS. Frequency: Very rare (HP:0040284). (ORPHA:464311)
- Hydronephrosis (HP:0000126): Severe distention of the kidney with dilation of the renal pelvis and calices. Evidence: TAS. Frequency: Very rare (HP:0040284). (ORPHA:464311)
- Retinal detachment (HP:0000541): Separation of the inner layers of the retina (neural retina) from the pigment epithelium. Evidence: TAS. Frequency: Very rare (HP:0040284). (ORPHA:464311)
- Polyhydramnios (HP:0001561): The presence of excess amniotic fluid in the uterus during pregnancy. Evidence: TAS. Frequency: Very rare (HP:0040284). (ORPHA:464311)
- Oligohydramnios (HP:0001562): Diminished amniotic fluid volume in pregnancy. Evidence: TAS. Frequency: Very rare (HP:0040284). (ORPHA:464311)
- Ventricular septal defect (HP:0001629): A hole between the two bottom chambers (ventricles) of the heart. The defect is centered around the most superior aspect of the ventricular septum. Evidence: TAS. Frequency: Very rare (HP:0040284). (ORPHA:464311)
- Patent ductus arteriosus (HP:0001643): In utero, the ductus arteriosus (DA) serves to divert ventricular output away from the lungs and toward the placenta by connecting the main pulmonary artery to the descending aorta. A patent ductus arteriosus (PDA) in the first 3 days of life is a physiologic shunt in healthy term and preterm newborn infants, and normally is substantially closed within about 24 hours after bith and completely closed after about three weeks. Failure of physiologcal closure is referred to a persistent or patent ductus arteriosus (PDA). Depending on the degree of left-to-right shunting, PDA can have clinical consequences. Evidence: TAS. Frequency: Very rare (HP:0040284). (ORPHA:464311)
- Aortic valve stenosis (HP:0001650): The presence of a stenosis (narrowing) of the aortic valve. Evidence: TAS. Frequency: Very rare (HP:0040284). (ORPHA:464311)
- Aortic regurgitation (HP:0001659): An insufficiency of the aortic valve, leading to regurgitation (backward flow) of blood from the aorta into the left ventricle. Evidence: TAS. Frequency: Very rare (HP:0040284). (ORPHA:464311)
- Duodenal atresia (HP:0002247): A developmental defect resulting in complete obliteration of the duodenal lumen, that is, an abnormal closure of the duodenum. Evidence: TAS. Frequency: Very rare (HP:0040284). (ORPHA:464311)
- Abnormality of neuronal migration (HP:0002269): An abnormality resulting from an anomaly of neuronal migration, i.e., of the process by which neurons travel from their origin to their final position in the brain. Evidence: TAS. Frequency: Very rare (HP:0040284). (ORPHA:464311)